- Metabolic acidosis (HP:0001942): Metabolic acidosis (MA) is characterized by a fall in blood pH due to a reduction of serum bicarbonate concentration. This can occur as a result of either the accumulation of acids (high anion gap MA) or the loss of bicarbonate from the gastrointestinal tract or the kidney (hyperchloremic MA). By definition, MA is not due to a respirary cause. Evidence: TAS. Frequency: Very frequent (HP:0040281). (ORPHA:31824)
- Dehydration (HP:0001944). Evidence: TAS. Frequency: Very frequent (HP:0040281). (ORPHA:31824)
- Increased total leukocyte count (HP:0001974): An abnormal increase in the number of leukocytes in the blood. Evidence: TAS. Frequency: Very frequent (HP:0040281). (ORPHA:31824)
- Vomiting (HP:0002013): Forceful ejection of the contents of the stomach through the mouth by means of a series of involuntary spasmic contractions. Evidence: TAS. Frequency: Very frequent (HP:0040281). (ORPHA:31824)
- Nausea (HP:0002018): A sensation of unease in the stomach together with an urge to vomit. Evidence: TAS. Frequency: Very frequent (HP:0040281). (ORPHA:31824)
- Respiratory distress (HP:0002098): Respiratory distress is objectively observable as the physical or emotional consequences from the experience of dyspnea. The physical presentation of respiratory distress is generally referred to as labored breathing, while the sensation of respiratory distress is called shortness of breath or dyspnea. Evidence: TAS. Frequency: Very frequent (HP:0040281). (ORPHA:31824)
- Hypotension (HP:0002615): Low Blood Pressure, vascular hypotension. Evidence: TAS. Frequency: Very frequent (HP:0040281). (ORPHA:31824)
- Renal insufficiency (HP:0000083): A reduction in the level of performance of the kidneys in areas of function comprising the concentration of urine, removal of wastes, the maintenance of electrolyte balance, homeostasis of blood pressure, and calcium metabolism. Evidence: TAS. Frequency: Frequent (HP:0040282). (ORPHA:31824)
- Congestive heart failure (HP:0001635): The presence of an abnormality of cardiac function that is responsible for the failure of the heart to pump blood at a rate that is commensurate with the needs of the tissues or a state in which abnormally elevated filling pressures are required for the heart to do so. Heart failure is frequently related to a defect in myocardial contraction. Evidence: TAS. Frequency: Frequent (HP:0040282). (ORPHA:31824)
- Abnormality of blood and blood-forming tissues (HP:0001871): An abnormality of the hematopoietic system. Evidence: TAS. Frequency: Frequent (HP:0040282). (ORPHA:31824)
- Diarrhea (HP:0002014): Abnormally increased frequency (usually defined as three or more) loose or watery bowel movements a day. Evidence: TAS. Frequency: Frequent (HP:0040282). (ORPHA:31824)
- Hypophosphatemia (HP:0002148): The concentration of phosphate ion in the blood circulation is below the lower limit of normal. Evidence: TAS. Frequency: Frequent (HP:0040282). (ORPHA:31824)
- Hypokalemia (HP:0002900): The concentration of potassium(1+) in the blood circulation is below the lower limit of normal. Evidence: TAS. Frequency: Frequent (HP:0040282). (ORPHA:31824)
- Hypocalcemia (HP:0002901): The concentration of calcium in the blood circulation is below the lower limit of normal. Evidence: TAS. Frequency: Frequent (HP:0040282). (ORPHA:31824)
- Hyponatremia (HP:0002902): The concentration of sodium in the blood circulation is below the lower limit of normal. Evidence: TAS. Frequency: Frequent (HP:0040282). (ORPHA:31824)
- Hypomagnesemia (HP:0002917): The concentration of magnesium in the blood circulation is below the lower limit of normal. Evidence: TAS. Frequency: Frequent (HP:0040282). (ORPHA:31824)
- Abnormal circulating electrolyte concentration (HP:0003111): Abnormality of the homeostasis (concentration) of a monoatomic ion. Evidence: TAS. Frequency: Frequent (HP:0040282). (ORPHA:31824)
- Lactic acidosis (HP:0003128): An abnormal buildup of lactic acid in the body, leading to acidification of the blood and other bodily fluids. Evidence: TAS. Frequency: Frequent (HP:0040282). (ORPHA:31824)
- Abnormality of acid-base homeostasis (HP:0004360): An abnormality of the balance or maintenance of the balance of acids and bases in bodily fluids, resulting in an abnormal pH. Evidence: TAS. Frequency: Frequent (HP:0040282). (ORPHA:31824)
- Reduced consciousness (HP:0004372): Abnormally diminished level of attention, responsiveness, or wakefulness. Evidence: TAS. Frequency: Frequent (HP:0040282). (ORPHA:31824)
- Disseminated intravascular coagulation (HP:0005521): Disseminated intravascular coagulation is characterized by the widespread activation of coagulation, which results in the intravascular formation of fibrin and ultimately thrombotic occlusion of small and midsize vessels. Evidence: TAS. Frequency: Frequent (HP:0040282). (ORPHA:31824)
- Cardiorespiratory arrest (HP:0006543). Evidence: TAS. Frequency: Frequent (HP:0040282). (ORPHA:31824)
- Acute encephalopathy (HP:0006846). Evidence: TAS. Frequency: Frequent (HP:0040282). (ORPHA:31824)
- Hypovolemia (HP:0011106): An decrease in the amount of intravascular fluid, particularly in the volume of the circulating blood. Evidence: TAS. Frequency: Frequent (HP:0040282). (ORPHA:31824)
- Arrhythmia (HP:0011675): Any cardiac rhythm other than the normal sinus rhythm. Such a rhythm may be either of sinus or ectopic origin and either regular or irregular. An arrhythmia may be due to a disturbance in impulse formation or conduction or both. Evidence: TAS. Frequency: Frequent (HP:0040282). (ORPHA:31824)
- Myocarditis (HP:0012819): Inflammation of the myocardium. Evidence: TAS. Frequency: Frequent (HP:0040282). (ORPHA:31824)
- Cardiogenic shock (HP:0030149): Severely decreased cardiac output with evidence of inadequate end-organ perfusion (i.e., tissue hypoxia) in the presence of adequate intravascular volume. Evidence: TAS. Frequency: Frequent (HP:0040282). (ORPHA:31824)
- Oliguria (HP:0100520): Low output of urine, clinically classified as an output below 300-500ml/day. Evidence: TAS. Frequency: Frequent (HP:0040282). (ORPHA:31824)
- Alopecia (HP:0001596): A noncongenital process of hair loss, which may progress to partial or complete baldness. Evidence: TAS. Frequency: Occasional (HP:0040283). (ORPHA:31824)
These phenotypes are associated with the disease Colchicine poisoning (ORPHA:31824).